Phenotypes associated with the disease Hirschsprung disease, cardiac defects, and autonomic dysfunction (OMIM:613870):
- Congenital onset (HP:0003577): A phenotypic abnormality that is present at birth. Evidence: PCS. Frequency: 1/1. (PMID:9915973)
- Micropenis (HP:0000054): Abnormally small penis. At birth, the normal penis is about 3 cm (stretched length from pubic tubercle to tip of penis) with micropenis less than 2.0-2.5 cm. Evidence: PCS. Frequency: 1/1. (PMID:9915973)
- Hyperconvex nail (HP:0001795): When viewed on end (with the digit tip pointing toward the examiner's eye) the curve of the nail forms a tighter curve of convexity. Evidence: PCS. Frequency: 1/1. (PMID:9915973)
- Status epilepticus (HP:0002133): Status epilepticus is a type of prolonged seizure resulting either from the failure of the mechanisms responsible for seizure termination or from the initiation of mechanisms which lead to abnormally prolonged seizures (after time point t1). It is a condition that can have long-term consequences (after time point t2), including neuronal death, neuronal injury, and alteration of neuronal networks, depending on the type and duration of seizures. Evidence: PCS. Frequency: 1/1. (PMID:9915973)
- Flexion contracture (HP:0001371): A flexion contracture is a bent (flexed) joint that cannot be straightened actively or passively. It is thus a chronic loss of joint motion due to structural changes in muscle, tendons, ligaments, or skin that prevents normal movement of joints. Evidence: PCS. Frequency: 1/1. (PMID:9915973)
- Short nose (HP:0003196): Distance from nasion to subnasale more than two standard deviations below the mean, or alternatively, an apparently decreased length from the nasal root to the nasal tip. Evidence: PCS. Frequency: 1/1. (PMID:9915973)
- Aganglionic megacolon (HP:0002251): An abnormality resulting from a lack of intestinal ganglion cells (i.e., an aganglionic section of bowel) that results in bowel obstruction with enlargement of the colon. Evidence: PCS. Frequency: 1/1. (PMID:9915973)
- Tapered finger (HP:0001182): The gradual reduction in girth of the finger from proximal to distal. Evidence: PCS. Frequency: 1/1. (PMID:9915973)
- Abnormal autonomic nervous system physiology (HP:0012332): A functional abnormality of the autonomic nervous system. Evidence: PCS. Frequency: 1/1. (PMID:9915973)
- Ventricular septal defect (HP:0001629): A hole between the two bottom chambers (ventricles) of the heart. The defect is centered around the most superior aspect of the ventricular septum. Evidence: PCS. Frequency: 1/1. (PMID:9915973)
- Hypertension (HP:0000822): The presence of chronic increased pressure in the systemic arterial system. Evidence: PCS. Frequency: 1/1. (PMID:9915973)
- Prominent nasal bridge (HP:0000426): Anterior positioning of the nasal root in comparison to the usual positioning for age. Evidence: PCS. Frequency: 1/1. (PMID:9915973)
- Bulbous nose (HP:0000414): Increased volume and globular shape of the anteroinferior aspect of the nose. Evidence: PCS. Frequency: 1/1. (PMID:9915973)
- Tachycardia (HP:0001649): A rapid heartrate that exceeds the range of the normal resting heartrate for age. Evidence: PCS. Frequency: 1/1. (PMID:9915973)
- Agitation (HP:0000713): A state of excessive motor activity that is associated with mental distress or a feeling of substantial unease or inner tension. Distinguished from restlessness by the increased level of emotional distress and negative intensity of the experience. Agitation has a significant level of physical activity that is typically threatening to the self or others. Evidence: PCS. Frequency: 1/1. (PMID:9915973)
- Cupped ear (HP:0000378): Laterally protruding ear that lacks antihelical folding (including absence of inferior and superior crura). Evidence: PCS. Frequency: 1/1. (PMID:9915973)
- Patent ductus arteriosus (HP:0001643): In utero, the ductus arteriosus (DA) serves to divert ventricular output away from the lungs and toward the placenta by connecting the main pulmonary artery to the descending aorta. A patent ductus arteriosus (PDA) in the first 3 days of life is a physiologic shunt in healthy term and preterm newborn infants, and normally is substantially closed within about 24 hours after bith and completely closed after about three weeks. Failure of physiologcal closure is referred to a persistent or patent ductus arteriosus (PDA). Depending on the degree of left-to-right shunting, PDA can have clinical consequences. Evidence: PCS. Frequency: 1/1. (PMID:9915973)
- Atrial septal defect (HP:0001631): Atrial septal defect (ASD) is a congenital abnormality of the interatrial septum that enables blood flow between the left and right atria via the interatrial septum. Evidence: PCS. Frequency: 1/1. (PMID:9915973)
- Autosomal dominant inheritance (HP:0000006): A mode of inheritance that is observed for traits related to a gene encoded on one of the autosomes (i.e., the human chromosomes 1-22) in which a trait manifests in heterozygotes. In the context of medical genetics, an autosomal dominant disorder is caused when a single copy of the mutant allele is present. Males and females are affected equally, and can both transmit the disorder with a risk of 50% for each child of inheriting the mutant allele. Evidence: PCS. (PMID:9915973)
- Posteriorly rotated ears (HP:0000358): A type of abnormal location of the ears in which the position of the ears is characterized by posterior rotation (the superior part of the ears is rotated towards the back of the head, and the inferior part of the ears towards the front). Evidence: PCS. Frequency: 1/1. (PMID:9915973)
- Interphalangeal thumb joint contracture (HP:0009626): Chronic loss of joint motion of the interphalangeal joint of the thumb due to structural changes in non-bony tissue. This joint is also called Articulatio interphalangealis pollicis. Evidence: PCS. Frequency: 1/1. (PMID:9915973)